- Hip dysplasia (HP:0001385): The presence of developmental dysplasia of the hip. Evidence: PCS. (PMID:23716478)
- Coxa valga (HP:0002673): Coxa valga is a deformity of the hip in which the angle between the femoral shaft and the femoral neck is increased compared to age-adjusted values (about 150 degrees in newborns gradually reducing to 120-130 degrees in adults). Evidence: IEA. (OMIM:615612)
- Hip pain (HP:0030838): An unpleasant sensation characterized by physical discomfort (such as pricking, throbbing, or aching) localized to the hip. Evidence: TAS. (OMIM:615612)
- Hip osteoarthritis (HP:0008843). Evidence: PCS. Frequency: 40%. (PMID:23716478)
- Autosomal dominant inheritance (HP:0000006): A mode of inheritance that is observed for traits related to a gene encoded on one of the autosomes (i.e., the human chromosomes 1-22) in which a trait manifests in heterozygotes. In the context of medical genetics, an autosomal dominant disorder is caused when a single copy of the mutant allele is present. Males and females are affected equally, and can both transmit the disorder with a risk of 50% for each child of inheriting the mutant allele. Evidence: TAS. (OMIM:615612)
- Arthritis (HP:0001369): Inflammation of a joint. Evidence: PCS. (PMID:23716478)
These phenotypes are associated with the disease developmental dysplasia of the hip 2 (OMIM:615612).